- Submucous cleft hard palate (HP:0000176): Hard-palate submucous clefts are characterized by bony defects in the midline of the bony palate that are covered by the mucous membrane of the roof of the mouth. It may be possible to detect a submucous cleft hard palate upon palpation as a notch in the bony palate. Evidence: TAS. Frequency: Very frequent (HP:0040281). (ORPHA:2804)
- Hypertelorism (HP:0000316): Interpupillary distance more than 2 SD above the mean (alternatively, the appearance of an increased interpupillary distance or widely spaced eyes). Evidence: TAS. Frequency: Very frequent (HP:0040281). (ORPHA:2804)
- Broad nasal tip (HP:0000455): Increase in width of the nasal tip. Evidence: TAS. Frequency: Very frequent (HP:0040281). (ORPHA:2804)
- Downslanted palpebral fissures (HP:0000494): The palpebral fissure inclination is more than two standard deviations below the mean. Evidence: TAS. Frequency: Very frequent (HP:0040281). (ORPHA:2804)
- Telecanthus (HP:0000506): Distance between the inner canthi more than two standard deviations above the mean (objective); or, apparently increased distance between the inner canthi. Evidence: TAS. Frequency: Very frequent (HP:0040281). (ORPHA:2804)
- Acne (HP:0001061): A skin condition in which there is an increase in sebum secretion by the pilosebaceous apparatus associated with open comedones (blackheads), closed comedones (whiteheads), and pustular nodules (papules, pustules, and cysts). Evidence: TAS. Frequency: Very frequent (HP:0040281). (ORPHA:2804)
- Alternating esotropia (HP:0001137): Esotropia in which either eye may be used for fixation. Evidence: TAS. Frequency: Very frequent (HP:0040281). (ORPHA:2804)
- Spasticity (HP:0001257): A motor disorder characterized by a velocity-dependent increase in tonic stretch reflexes with increased muscle tone, exaggerated (hyperexcitable) tendon reflexes. Evidence: TAS. Frequency: Very frequent (HP:0040281). (ORPHA:2804)
- Global developmental delay (HP:0001263): A delay in the achievement of motor or mental milestones in the domains of development of a child, including motor skills, speech and language, cognitive skills, and social and emotional skills. This term should only be used to describe children younger than five years of age. Evidence: TAS. Frequency: Very frequent (HP:0040281). (ORPHA:2804)
- Pes cavus (HP:0001761): An increase in height of the medial longitudinal arch of the foot that does not flatten on weight bearing (i.e., a distinctly hollow form of the sole of the foot when it is bearing weight). Evidence: TAS. Frequency: Very frequent (HP:0040281). (ORPHA:2804)
- Pes planus (HP:0001763): A foot where the longitudinal arch of the foot is in contact with the ground or floor when the individual is standing; or, in a patient lying supine, a foot where the arch is in contact with the surface of a flat board pressed against the sole of the foot by the examiner with a pressure similar to that expected from weight bearing; or, the height of the arch is reduced. Evidence: TAS. Frequency: Very frequent (HP:0040281). (ORPHA:2804)
- Metatarsus adductus (HP:0001840): The metatarsals are deviated medially (tibially), that is, the bones in the front half of the foot bend or turn in toward the body. Evidence: TAS. Frequency: Very frequent (HP:0040281). (ORPHA:2804)
- Bilateral tonic-clonic seizure (HP:0002069): A bilateral tonic-clonic seizure is a seizure defined by a tonic (bilateral increased tone, lasting seconds to minutes) and then a clonic (bilateral sustained rhythmic jerking) phase. Evidence: TAS. Frequency: Very frequent (HP:0040281). (ORPHA:2804)
- Cubitus valgus (HP:0002967): Abnormal positioning in which the elbows are turned out. Evidence: TAS. Frequency: Very frequent (HP:0040281). (ORPHA:2804)
- Radial bowing (HP:0002986): A bending or abnormal curvature of the radius. Evidence: TAS. Frequency: Very frequent (HP:0040281). (ORPHA:2804)
- Hypoplasia of the ulna (HP:0003022): Underdevelopment of the ulna. Evidence: TAS. Frequency: Very frequent (HP:0040281). (ORPHA:2804)
- Elbow dislocation (HP:0003042): Dislocation of the distal humerus out of the elbow joint, where the radius, ulna, and humerus meet. Evidence: TAS. Frequency: Very frequent (HP:0040281). (ORPHA:2804)
- Depressed nasal bridge (HP:0005280): Posterior positioning of the nasal root in relation to the overall facial profile for age. Evidence: TAS. Frequency: Very frequent (HP:0040281). (ORPHA:2804)
- Agenesis of maxillary central incisor (HP:0006293): Agenesis of upper secondary incisor or of upper central primary incisor. Evidence: TAS. Frequency: Very frequent (HP:0040281). (ORPHA:2804)
- Broad uvula (HP:0010809): Increased width of the uvula (subjective finding). Evidence: TAS. Frequency: Very frequent (HP:0040281). (ORPHA:2804)
- Prominent forehead (HP:0011220): Forward prominence of the entire forehead, due to protrusion of the frontal bone. Evidence: TAS. Frequency: Very frequent (HP:0040281). (ORPHA:2804)
- Camptodactyly (HP:0012385): The distal interphalangeal joint and/or the proximal interphalangeal joint of the fingers or toes cannot be extended to 180 degrees by either active or passive extension. Evidence: TAS. Frequency: Very frequent (HP:0040281). (ORPHA:2804)
- Clinodactyly (HP:0030084): An angulation of a digit at an interphalangeal joint in the plane of the palm (finger) or sole (toe). Evidence: TAS. Frequency: Very frequent (HP:0040281). (ORPHA:2804)
- Abnormality of the scalp hair (HP:0100037): An abnormality of the hair of head. Evidence: TAS. Frequency: Very frequent (HP:0040281). (ORPHA:2804)
- Upper lip pit (HP:0100268): Depression located on the vermilion of the upper lip, usually paramedian. Evidence: TAS. Frequency: Very frequent (HP:0040281). (ORPHA:2804)
These phenotypes are associated with the disease W syndrome (ORPHA:2804).